- Rhinorrhea (HP:0031417): Increased discharge of mucus from the nose. Evidence: PCS. Frequency: 1/2. (PMID:30388400)
- Congenital onset (HP:0003577): A phenotypic abnormality that is present at birth. Evidence: PCS. (PMID:30388400)
- Chronic lung disease (HP:0006528): According to the definitions of the American and British Thoracic Societies, including pulmonary functional tests, X-rays, and CT scans for items such as fibrosis, bronchiectasis, bullae, emphysema, nodular or lymphomatous abnormalities. Evidence: PCS. Frequency: 2/2. (PMID:30388400)
- Dextrocardia (HP:0001651): The heart is located in the right hand sided hemithorax. That is, there is a left-right reversal (or "mirror reflection") of the anatomical location of the heart in which the heart is locate on the right side instead of the left. Evidence: PCS. Frequency: 1/4. (PMID:30388400)
- Recurrent lower respiratory tract infections (HP:0002783): An increased susceptibility to lower respiratory tract infections as manifested by a history of recurrent lower respiratory tract infections. Evidence: PCS. Frequency: 2/2. (PMID:30388400)
- Bronchiectasis (HP:0002110): Persistent abnormal dilatation of the bronchi owing to localized and irreversible destruction and widening of the large airways. Evidence: PCS. Frequency: 1/2. (PMID:30388400)
- Double outlet right ventricle (HP:0001719): Double outlet right ventricle (DORV) is a type of ventriculoarterial connection in which both great vessels arise entirely or predominantly from the right ventricle. Evidence: PCS. Frequency: 2/2. (PMID:30388400)
- Decreased nasal nitric oxide (HP:0033036): Reduced level of nasal nitric oxide (nNO). Current American Thoracic Society/European Respiratory Society (ATS/ERS) guidelines for nNO measurements recommend air aspiration via a nasal probe while the subject exhales through the mouth against resistance in order to maintain velum closure. Evidence: PCS. Frequency: 1/1. (PMID:30388400)
- Autosomal recessive inheritance (HP:0000007): A mode of inheritance that is observed for traits related to a gene encoded on one of the autosomes (i.e., the human chromosomes 1-22) in which a trait manifests in individuals with two pathogenic alleles, either homozygotes (two copies of the same mutant allele) or compound heterozygotes (whereby each copy of a gene has a distinct mutant allele). Evidence: PCS. (PMID:30388400)
- Cough (HP:0012735): A sudden, audible expulsion of air from the lungs through a partially closed glottis, preceded by inhalation. Evidence: PCS. Frequency: 2/2. (PMID:30388400)
- Recurrent otitis media (HP:0000403): Increased susceptibility to otitis media, as manifested by recurrent episodes of otitis media. Evidence: PCS. Frequency: 2/2. (PMID:30388400)
These phenotypes are associated with the disease ciliary dyskinesia, primary, 39 (OMIM:618254).